Phenotypes associated with the disease spinocerebellar ataxia type 32 (OMIM:613909):
- Cognitive impairment (HP:0100543): Abnormal cognition is characterized by deficits in thinking, reasoning, or remembering. Evidence: IEA. (OMIM:613909)
- Cerebellar atrophy (HP:0001272): Cerebellar atrophy is defined as a cerebellum with initially normal structures, in a posterior fossa with normal size, which displays enlarged fissures (interfolial spaces) in comparison to the foliae secondary to loss of tissue. Cerebellar atrophy implies irreversible loss of tissue and result from an ongoing progressive disease until a final stage is reached or a single injury, e.g. an intoxication or infectious event. Evidence: TAS. (OMIM:613909)
- Ataxia (HP:0001251): Ataxia refers to impaired coordination of voluntary muscle movement. Cerebellar ataxia refers to ataxia due to dysfunction of the cerebellum. This causes a variety of elementary neurological deficits including asynergy (lack of coordination between muscles, limbs and joints), dysmetria (lack of ability to judge distances that can lead to under- or overshoot in grasping movements), and dysdiadochokinesia (inability to perform rapid movements requiring antagonizing muscle groups to be switched on and off repeatedly). Evidence: TAS. (OMIM:613909)
- Infertility (HP:0000789). Evidence: TAS. (OMIM:613909)
- Testicular atrophy (HP:0000029): Wasting (atrophy) of the testicle (the male gonad) manifested by a decrease in size and potentially by a loss of fertility. Evidence: TAS. (OMIM:613909)
- Autosomal dominant inheritance (HP:0000006): A mode of inheritance that is observed for traits related to a gene encoded on one of the autosomes (i.e., the human chromosomes 1-22) in which a trait manifests in heterozygotes. In the context of medical genetics, an autosomal dominant disorder is caused when a single copy of the mutant allele is present. Males and females are affected equally, and can both transmit the disorder with a risk of 50% for each child of inheriting the mutant allele. Evidence: TAS. (OMIM:613909)
- Azoospermia (HP:0000027): Absence of any measurable level of sperm,whereby spermatozoa cannot be observed even after centrifugation of the semen pellet. Evidence: TAS. (OMIM:613909)